Phenotypes associated with the disease Adrenocortical carcinoma (ORPHA:1501):
- Adrenocortical carcinoma (HP:0006744): A malignant neoplasm of the adrenal cortex that may produce hormones such as cortisol, aldosterone, estrogen, or testosterone. Evidence: TAS. Frequency: Obligate (HP:0040280). (ORPHA:1501)
- Abnormality of reproductive system physiology (HP:0000080): An abnormal functionality of the genital system. Evidence: TAS. Frequency: Frequent (HP:0040282). (ORPHA:1501)
- Irritability (HP:0000737): An emotional state characterized by negative feelings of heightened frustration, annoyance, or feeling upset, often triggered by internal factors (e.g., fatigue, hunger, unfulfilled desires) or external factors (e.g., social or environmental challenges). Irritability may be unpredictable, and is accompanied by a lowered threshold for emotional reactivity and observable features (speech, facial expressions, or psychomotor activity). Evidence: TAS. Frequency: Frequent (HP:0040282). (ORPHA:1501)
- Anxiety (HP:0000739): Intense feelings of nervousness, tension, or panic often arise in response to interpersonal stresses. There is worry about the negative effects of past unpleasant experiences and future negative possibilities. Individuals may feel fearful, apprehensive, or threatened by uncertainty, and they may also have fears of falling apart or losing control. Evidence: TAS. Frequency: Frequent (HP:0040282). (ORPHA:1501)
- Diabetes mellitus (HP:0000819): A group of abnormalities characterized by hyperglycemia and glucose intolerance. Evidence: TAS. Frequency: Frequent (HP:0040282). (ORPHA:1501)
- Hypertension (HP:0000822): The presence of chronic increased pressure in the systemic arterial system. Evidence: TAS. Frequency: Frequent (HP:0040282). (ORPHA:1501)
- Increased circulating aldosterone concentration (HP:0000859): Overproduction of the mineralocorticoid aldosterone by the adrenal cortex. Evidence: TAS. Frequency: Frequent (HP:0040282). (ORPHA:1501)
- Hyperhidrosis (HP:0000975): Abnormal excessive perspiration (sweating) despite the lack of appropriate stimuli like hot and humid weather. Evidence: TAS. Frequency: Frequent (HP:0040282). (ORPHA:1501)
- Hypertrichosis (HP:0000998): Hypertrichosis is increased hair growth that is abnormal in quantity or location. Evidence: TAS. Frequency: Frequent (HP:0040282). (ORPHA:1501)
- Striae distensae (HP:0001065): Thinned, erythematous, depressed bands of atrophic skin. Initially, striae appear as flattened and thinned, pinkish linear regions of the skin. Striae tend to enlarge in length and become reddish or purplish. Later, striae tend to appear as white, depressed bands that are parallel to the lines of skin tension. Striae distensae occur most often in areas that have been subject to distension such as the lower back, buttocks, thighs, breast, abdomen, and shoulders. Evidence: TAS. Frequency: Frequent (HP:0040282). (ORPHA:1501)
- Muscle weakness (HP:0001324): Reduced strength of muscles. Evidence: TAS. Frequency: Frequent (HP:0040282). (ORPHA:1501)
- Weight loss (HP:0001824): Reduction of total body weight. Evidence: TAS. Frequency: Frequent (HP:0040282). (ORPHA:1501)
- Abnormality of metabolism/homeostasis (HP:0001939). Evidence: TAS. Frequency: Frequent (HP:0040282). (ORPHA:1501)
- Palpitations (HP:0001962): A sensation that the heart is pounding or racing, which is a non-specific sign but may be a manifestation of arrhythmia. Evidence: TAS. Frequency: Frequent (HP:0040282). (ORPHA:1501)
- Abdominal pain (HP:0002027): An unpleasant sensation characterized by physical discomfort (such as pricking, throbbing, or aching) and perceived to originate in the abdomen. Evidence: TAS. Frequency: Frequent (HP:0040282). (ORPHA:1501)
- Hypokalemia (HP:0002900): The concentration of potassium(1+) in the blood circulation is below the lower limit of normal. Evidence: TAS. Frequency: Frequent (HP:0040282). (ORPHA:1501)
- Increased circulating cortisol level (HP:0003118): Overproduction of the hormone of cortisol by the adrenal cortex, resulting in a characteristic combination of clinical symptoms termed Cushing syndrome, with truncal obesity, a round, full face, striae atrophicae and acne, muscle weakness, and other features. Evidence: TAS. Frequency: Frequent (HP:0040282). (ORPHA:1501)
- Paradoxical increased cortisol secretion on dexamethasone suppression test (HP:0003466). Evidence: TAS. Frequency: Frequent (HP:0040282). (ORPHA:1501)
- Increased body weight (HP:0004324): Abnormally increased body weight. Evidence: TAS. Frequency: Frequent (HP:0040282). (ORPHA:1501)
- Adrenocorticotropic hormone deficiency (HP:0011748): A reduced ability to secrete adrenocorticotropic hormone (ACTH), a hormone that stimulates the adrenal cortex to secrete of glucocorticoids such as cortisol. Evidence: TAS. Frequency: Frequent (HP:0040282). (ORPHA:1501)
- Increased urinary cortisol level (HP:0012030): Abnormally increased concentration of cortisol in the urine. Evidence: TAS. Frequency: Frequent (HP:0040282). (ORPHA:1501)
- Increased serum estradiol (HP:0025134): An elevation above normal limits of the concentration of estradiol in the circulation. Evidence: TAS. Frequency: Frequent (HP:0040282). (ORPHA:1501)
- Panic attack (HP:0025269): A sudden episode of intense fear in a situation where there is no danger or apparent cause. Evidence: TAS. Frequency: Frequent (HP:0040282). (ORPHA:1501)
- Increased circulating androstenedione concentration (HP:0025380): Increased concentration of androstenedione in the blood circulation. Evidence: TAS. Frequency: Frequent (HP:0040282). (ORPHA:1501)
- Elevated serum 11-deoxycortisol (HP:0025436): Increased concentration of 11-deoxycortisol in the circulation. 11-deoxycorticosterone, which is also known as simply deoxycorticosterone and 21-hydroxyprogesterone, is a steroid hormore that is produces in the adrenals and is a precursor to aldosterone. Evidence: TAS. Frequency: Frequent (HP:0040282). (ORPHA:1501)
- Lung adenocarcinoma (HP:0030078). Evidence: TAS. Frequency: Frequent (HP:0040282). (ORPHA:1501)
- Increased circulating androgen concentration (HP:0030348): An elevation of the blood concentration of an androgen, that is, of a steroid hormone that controls development and maintenance of masculine characteristics. The androgens include testosterone and Dehydroepiandrosterone. Evidence: TAS. Frequency: Frequent (HP:0040282). (ORPHA:1501)
- Abnormal circulating dehydroepiandrosterone concentration (HP:0500022): A deviation from the normal concentration of dehydroepiandrosterone in the circulation. Evidence: TAS. Frequency: Frequent (HP:0040282). (ORPHA:1501)
- Abnormality of urine homeostasis (HP:0003110): An abnormality of the composition of urine or the levels of its components. Evidence: TAS. Frequency: Occasional (HP:0040283). (ORPHA:1501)